Phenotypes associated with the disease Oguchi disease-2 (OMIM:613411):
- Autosomal recessive inheritance (HP:0000007): A mode of inheritance that is observed for traits related to a gene encoded on one of the autosomes (i.e., the human chromosomes 1-22) in which a trait manifests in individuals with two pathogenic alleles, either homozygotes (two copies of the same mutant allele) or compound heterozygotes (whereby each copy of a gene has a distinct mutant allele). Evidence: PCS. (PMID:17070587)
- Early-onset non-progressive night blindness (HP:0007642): A usually nonprogressive (i.e., stationary) form of night blindness with early (presumed to be congenital) onset. Evidence: PCS. (PMID:17070587)
- Mizuo phenomenon (HP:0030824): Change in the color of the fundus from red in the dark-adapted state to golden immediately or shortly after the onset of the light. The color of the fundus reflex in the light adapted state has also been described as golden-yellow, gray-white, and yellow-white. This reflex can appear either homogeneous or in streaks in the fundus. The retinal vessels appear to be protruding in contrast to the radiant background. Dark adaptation leads to disappearance of the unusual fundus coloration [Digital Journal of Ophthalmology 2008; Volume 14, Number 14]. Evidence: PCS. (PMID:17070587)